- Progressive (HP:0003676): Applies to a disease manifestation that increases in scope or severity over the course of time, i.e., that worsens with age. Evidence: TAS. (OMIM:615342)
- Juvenile onset (HP:0003621): Onset of signs or symptoms of disease between the age of 5 and 15 years. Evidence: PCS. Frequency: 1/1. (PMID:19211612)
- Typified by incomplete penetrance (HP:0003829): Description of conditions in which not all individuals with a given genotype exhibit the disease. Penetrance is the proportion that develop disease given a lifespan of 80 years. Evidence: PCS. (PMID:19211612)
- Pulmonary arterial hypertension (HP:0002092): Pulmonary hypertension is defined mean pulmonary artery pressure of 25mmHg or more and pulmonary capillary wedge pressure of 15mmHg or less when measured by right heart catheterisation at rest and in a supine position. Evidence: PCS. Frequency: 1/2. (PMID:19211612)
- Abnormally loud pulmonic component of the second heart sound (HP:0031687). Evidence: PCS. Frequency: 1/2. (PMID:19211612)
- Increased pulmonary vascular resistance (HP:0005317): Pulmonary vascular resistance (PVR) more than 3 wood units, as defined by the current definition of pulmonary hypertension. 95% of individuals have a PVR of less than 2.4 wood units. Evidence: PCS. Frequency: 1/1. (PMID:19211612)
- Autosomal dominant inheritance (HP:0000006): A mode of inheritance that is observed for traits related to a gene encoded on one of the autosomes (i.e., the human chromosomes 1-22) in which a trait manifests in heterozygotes. In the context of medical genetics, an autosomal dominant disorder is caused when a single copy of the mutant allele is present. Males and females are affected equally, and can both transmit the disorder with a risk of 50% for each child of inheriting the mutant allele. Evidence: PCS. (PMID:19211612)
These phenotypes are associated with the disease pulmonary hypertension, primary, 2 (OMIM:615342).